- Hypertriglyceridemia (HP:0002155): An abnormal increase in the level of triglycerides in the blood. Evidence: TAS. (OMIM:108725)
- Decreased circulating HDL-C concentration (HP:0003233): The concentration of high-density lipoprotein cholesterol in the blood circulation is below the lower limit of normal. Evidence: TAS. (OMIM:108725)
- Myocardial infarction (HP:0001658): Necrosis of the myocardium caused by an obstruction of the blood supply to the heart and often associated with chest pain, shortness of breath, palpitations, and anxiety as well as characteristic EKG findings and elevation of serum markers including creatine kinase-MB fraction and troponin. Evidence: TAS. (OMIM:108725)
- Autosomal dominant inheritance (HP:0000006): A mode of inheritance that is observed for traits related to a gene encoded on one of the autosomes (i.e., the human chromosomes 1-22) in which a trait manifests in heterozygotes. In the context of medical genetics, an autosomal dominant disorder is caused when a single copy of the mutant allele is present. Males and females are affected equally, and can both transmit the disorder with a risk of 50% for each child of inheriting the mutant allele. Evidence: IEA. (OMIM:108725)
These phenotypes are associated with the disease atherosclerosis susceptibility (OMIM:108725).